- Keratoconus (HP:0000563): A cone-shaped deformity of the cornea characterized by the presence of corneal distortion secondary to thinning of the apex. Evidence: TAS. Frequency: Occasional (HP:0040283). (OMIM:604393)
- Nyctalopia (HP:0000662): Inability to see well at night or in poor light. Evidence: TAS. (OMIM:604393)
- Pendular nystagmus (HP:0012043): Rhythmic, involuntary sinusoidal oscillations of one or both eyes. The waveform of pendular nystagmus may occur in any direction. Evidence: TAS. (OMIM:604393)
- Blindness (HP:0000618): Blindness is the condition of lacking visual perception defined as a profound reduction in visual perception. On the 6m visual acuity scale, blindness is defined as less than 3/60. On the 20ft visual acuity scale, blindness is defined as less than 20/400. On the decimal visual acuity scale, blindness is defined as less than 0.05. Blindness is typically characterized by a visual field of no greater than 10 degrees in radius around central fixation. Evidence: IEA. (OMIM:604393)
- Autosomal recessive inheritance (HP:0000007): A mode of inheritance that is observed for traits related to a gene encoded on one of the autosomes (i.e., the human chromosomes 1-22) in which a trait manifests in individuals with two pathogenic alleles, either homozygotes (two copies of the same mutant allele) or compound heterozygotes (whereby each copy of a gene has a distinct mutant allele). Evidence: TAS. (OMIM:604393)
- Reduced visual acuity (HP:0007663). Evidence: TAS. (OMIM:604393)
- Macular atrophy (HP:0007401): A nonspecific term denoting wasting, especially as a result of degeneration, of the retinal pigment epithelium (RPE) and neurosensory retinal cells in the macula. Evidence: TAS. (OMIM:604393)
- Cone/cone-rod dystrophy (HP:0000548). Evidence: IEA. (OMIM:604393)
- Optic disc pallor (HP:0000543): A pale yellow discoloration of the optic disc (the area of the optic nerve head in the retina). The optic disc normally has a pinkish hue with a central yellowish depression. Evidence: TAS. (OMIM:604393)
- Undetectable light- and dark-adapted electroretinogram (HP:0007688): Absence of the combined rod-and-cone response on electroretinogram. Evidence: TAS. (OMIM:604393)
- Attenuation of retinal blood vessels (HP:0007843): Narrowing of the retinal blood vessels, both arterioles and venules. Evidence: TAS. (OMIM:604393)
- Autosomal dominant inheritance (HP:0000006): A mode of inheritance that is observed for traits related to a gene encoded on one of the autosomes (i.e., the human chromosomes 1-22) in which a trait manifests in heterozygotes. In the context of medical genetics, an autosomal dominant disorder is caused when a single copy of the mutant allele is present. Males and females are affected equally, and can both transmit the disorder with a risk of 50% for each child of inheriting the mutant allele. Evidence: TAS. (OMIM:604393)
These phenotypes are associated with the disease Leber congenital amaurosis 4 (OMIM:604393).